- Acne inversa (HP:0040154): A chronic skin condition involving the inflammation of the apocrine sweat glands, forming pimple-like bumps known as abscesses. Evidence: IEA. (OMIM:142690)
- Atypical scarring of skin (HP:0000987): Atypically scarred skin . Evidence: IEA. (OMIM:142690)
- Autosomal dominant inheritance (HP:0000006): A mode of inheritance that is observed for traits related to a gene encoded on one of the autosomes (i.e., the human chromosomes 1-22) in which a trait manifests in heterozygotes. In the context of medical genetics, an autosomal dominant disorder is caused when a single copy of the mutant allele is present. Males and females are affected equally, and can both transmit the disorder with a risk of 50% for each child of inheriting the mutant allele. Evidence: IEA. (OMIM:142690)
These phenotypes are associated with the disease acne inversa, familial, 1 (OMIM:142690).